Phenotypes associated with the disease intellectual developmental disorder with autism and speech delay (OMIM:606053):
- Delayed speech and language development (HP:0000750): A degree of language development that is significantly below the norm for a child of a specified age. Evidence: IEA. (OMIM:606053)
- Inability to walk (HP:0002540): Incapability to ambulate. Evidence: IEA. (OMIM:606053)
- Delayed ability to walk (HP:0031936): A failure to achieve the ability to walk at an appropriate developmental stage. Most children learn to walk in a series of stages, and learn to walk short distances independently between 12 and 15 months. Evidence: IEA. (OMIM:606053)
- Joint hypermobility (HP:0001382): The capability that a joint (or a group of joints) has to move, passively and/or actively, beyond normal limits along physiological axes. Evidence: IEA. Frequency: Very rare (HP:0040284). (OMIM:606053)
- Global developmental delay (HP:0001263): A delay in the achievement of motor or mental milestones in the domains of development of a child, including motor skills, speech and language, cognitive skills, and social and emotional skills. This term should only be used to describe children younger than five years of age. Evidence: IEA. (OMIM:606053)
- Infantile onset (HP:0003593): Onset of signs or symptoms of disease between 28 days to one year of life. Evidence: IEA. (OMIM:606053)
- Generalized hypotonia (HP:0001290): Generalized muscular hypotonia (abnormally low muscle tone). Evidence: IEA. (OMIM:606053)
- Severe intellectual disability (HP:0010864): Severe intellectual disability (ID) is defined as a type of ID characterized by severely sub-average adaptive functioning and intellectual functioning, with an intelligence quotient (IQ) the range of 20-34. Evidence: IEA. Frequency: 2/2. (PMID:30268909)
- Reduced social responsiveness (HP:0012760): A reduced ability to participate in the back-and-forth flow of social interaction appropriate to culture and developmental level, which is normally characterized by an influence of the behavior of one person on the behavior of another person. This results in difficulty interacting with others through emotional, physical, or verbal communication. Evidence: IEA. (OMIM:606053)
- Autism (HP:0000717): Autism is a neurodevelopmental disorder characterized by impaired social interaction and communication, and by restricted and repetitive behavior. Autism begins in childhood. It is marked by the presence of markedly abnormal or impaired development in social interaction and communication and a markedly restricted repertoire of activity and interest. Manifestations of the disorder vary greatly depending on the developmental level and chronological age of the individual (DSM-IV). Evidence: IEA. (OMIM:606053)
- Motor stereotypy (HP:0000733): Use of the same abnormal action in response to certain triggers or at random. They may be used as a way to regulate one's internal state but must otherwise have no apparent functional purpose. Evidence: IEA. (OMIM:606053)
- Pachygyria (HP:0001302): Pachygyria is a malformation of cortical development with abnormally wide gyri with sulci 1,5-3 cm apart and abnormally thick cortex measuring more than 5 mm (radiological definition). See also neuropathological definitions for 2-, 3-, and 4-layered lissencephaly. Evidence: IEA. Frequency: Very rare (HP:0040284). (OMIM:606053)
- Autosomal dominant inheritance (HP:0000006): A mode of inheritance that is observed for traits related to a gene encoded on one of the autosomes (i.e., the human chromosomes 1-22) in which a trait manifests in heterozygotes. In the context of medical genetics, an autosomal dominant disorder is caused when a single copy of the mutant allele is present. Males and females are affected equally, and can both transmit the disorder with a risk of 50% for each child of inheriting the mutant allele. Evidence: PCS. (PMID:30268909)